Phenotypes associated with the disease autosomal dominant nonsyndromic hearing loss 13 (OMIM:601868):
- Sensorineural hearing impairment (HP:0000407): A type of hearing impairment in one or both ears related to an abnormal functionality of the cochlear nerve. Evidence: TAS. Onset: Congenital onset (HP:0003577). (OMIM:601868)
- Autosomal dominant inheritance (HP:0000006): A mode of inheritance that is observed for traits related to a gene encoded on one of the autosomes (i.e., the human chromosomes 1-22) in which a trait manifests in heterozygotes. In the context of medical genetics, an autosomal dominant disorder is caused when a single copy of the mutant allele is present. Males and females are affected equally, and can both transmit the disorder with a risk of 50% for each child of inheriting the mutant allele. Evidence: IEA. (OMIM:601868)